Phenotypes associated with the disease Ehlers-Danlos syndrome, fibronectinemic type (OMIM:225310):
- Joint hypermobility (HP:0001382): The capability that a joint (or a group of joints) has to move, passively and/or actively, beyond normal limits along physiological axes. Evidence: IEA. (OMIM:225310)
- Striae distensae (HP:0001065): Thinned, erythematous, depressed bands of atrophic skin. Initially, striae appear as flattened and thinned, pinkish linear regions of the skin. Striae tend to enlarge in length and become reddish or purplish. Later, striae tend to appear as white, depressed bands that are parallel to the lines of skin tension. Striae distensae occur most often in areas that have been subject to distension such as the lower back, buttocks, thighs, breast, abdomen, and shoulders. Evidence: IEA. (OMIM:225310)
- Atypical scarring of skin (HP:0000987): Atypically scarred skin . Evidence: IEA. (OMIM:225310)
- Autosomal recessive inheritance (HP:0000007): A mode of inheritance that is observed for traits related to a gene encoded on one of the autosomes (i.e., the human chromosomes 1-22) in which a trait manifests in individuals with two pathogenic alleles, either homozygotes (two copies of the same mutant allele) or compound heterozygotes (whereby each copy of a gene has a distinct mutant allele). Evidence: IEA. (OMIM:225310)
- Petechiae (HP:0000967): Petechiae are pinpoint-sized reddish/purple spots, resembling a rash, that appear just under the skin or a mucous membrane when capillaries have ruptured and some superficial bleeding into the skin has happened. This term refers to an abnormally increased susceptibility to developing petechiae. Evidence: IEA. (OMIM:225310)
- Bruising susceptibility (HP:0000978): An ecchymosis (bruise) refers to the skin discoloration caused by the escape of blood into the tissues from ruptured blood vessels. This term refers to an abnormally increased susceptibility to bruising. The corresponding phenotypic abnormality is generally elicited on medical history as a report of frequent ecchymoses or bruising without adequate trauma. Evidence: IEA. (OMIM:225310)
- Thin skin (HP:0000963): Reduction in thickness of the skin, generally associated with a loss of suppleness and elasticity of the skin. Evidence: IEA. (OMIM:225310)
- Hyperextensible skin (HP:0000974): A condition in which the skin can be stretched beyond normal, and then returns to its initial position. Evidence: IEA. (OMIM:225310)
- Mitral valve prolapse (HP:0001634): One or both of the leaflets (cusps) of the mitral valve bulges back into the left atrium upon contraction of the left ventricle. Evidence: IEA. (OMIM:225310)